- Oromandibular dystonia (HP:0012048): A kind of focal dystonia characterized by forceful contractions of the face, jaw, and/or tongue causing difficulty in opening and closing the mouth and often affecting chewing and speech. Evidence: TAS. Frequency: Very frequent (HP:0040281). (ORPHA:464440)
- Laryngeal dystonia (HP:0012049): A form of focal dystonia that affects the vocal cords, associated with involuntary contractions of the vocal cords causing interruptions of speech and affecting the voice quality and often leading to patterned, repeated breaks in speech. Evidence: TAS. Frequency: Very frequent (HP:0040281). (ORPHA:464440)
- Action tremor (HP:0002345): A tremor present when the limbs are active, either when outstretched in a certain position or throughout a voluntary movement. Evidence: TAS. Frequency: Frequent (HP:0040282). (ORPHA:464440)
- Writer's cramp (HP:0002356): A focal dystonia of the fingers, hand, and/or forearm that appears when the affected person attempts to do a task that requires fine motor movements such as writing or playing a musical instrument. Evidence: TAS. Frequency: Frequent (HP:0040282). (ORPHA:464440)
- Limb dystonia (HP:0002451): A type of dystonia (abnormally increased muscular tone causing fixed abnormal postures) that affects muscles of the limbs. Evidence: TAS. Frequency: Frequent (HP:0040282). (ORPHA:464440)
- Axial dystonia (HP:0002530): A type of dystonia that affects the midline muscles, i.e., the chest, abdominal, and back muscles. Evidence: TAS. Frequency: Frequent (HP:0040282). (ORPHA:464440)
- Focal dystonia (HP:0004373): A type of dystonia that is localized to a specific part of the body. Evidence: TAS. Frequency: Frequent (HP:0040282). (ORPHA:464440)
- Upper limb postural tremor (HP:0007351): A type of tremors that is triggered by holding an arm in a fixed position. Evidence: TAS. Frequency: Frequent (HP:0040282). (ORPHA:464440)
These phenotypes are associated with the disease Primary dystonia, DYT27 type (ORPHA:464440).